- X-linked inheritance (HP:0001417): A mode of inheritance that is observed for traits related to a gene encoded on the X chromosome. Evidence: TAS. (OMIM:301120)
- Prostate cancer (HP:0012125): A cancer of the prostate. Evidence: PCS. (PMID:10589774)
These phenotypes are associated with the disease prostate cancer, hereditary, X-linked 3 (OMIM:301120).